- Colon cancer (HP:0003003). Evidence: PCS. (PMID:8145827)
- Autosomal dominant inheritance (HP:0000006): A mode of inheritance that is observed for traits related to a gene encoded on one of the autosomes (i.e., the human chromosomes 1-22) in which a trait manifests in heterozygotes. In the context of medical genetics, an autosomal dominant disorder is caused when a single copy of the mutant allele is present. Males and females are affected equally, and can both transmit the disorder with a risk of 50% for each child of inheriting the mutant allele. Evidence: PCS. (PMID:8145827)
These phenotypes are associated with the disease Lynch syndrome 2 (OMIM:609310).